Phenotypes associated with the disease Frontonasal dysplasia-bifid nose-upper limb anomalies syndrome (ORPHA:521308):
- Thin upper lip vermilion (HP:0000219): Height of the vermilion of the upper lip in the midline more than 2 SD below the mean. Alternatively, an apparently reduced height of the vermilion of the upper lip in the frontal view (subjective). Evidence: TAS. Frequency: Frequent (HP:0040282). (ORPHA:521308)
- Hypertelorism (HP:0000316): Interpupillary distance more than 2 SD above the mean (alternatively, the appearance of an increased interpupillary distance or widely spaced eyes). Evidence: TAS. Frequency: Frequent (HP:0040282). (ORPHA:521308)
- Facial asymmetry (HP:0000324): An abnormal difference between the left and right sides of the face. Evidence: TAS. Frequency: Frequent (HP:0040282). (ORPHA:521308)
- Underdeveloped nasal alae (HP:0000430): Thinned, deficient, or excessively arched ala nasi. Evidence: TAS. Frequency: Frequent (HP:0040282). (ORPHA:521308)
- Wide nasal bridge (HP:0000431): Increased breadth of the nasal bridge (and with it, the nasal root). Evidence: TAS. Frequency: Frequent (HP:0040282). (ORPHA:521308)
- Wide nose (HP:0000445): Interalar distance more than two standard deviations above the mean for age, i.e., an apparently increased width of the nasal base and alae. Evidence: TAS. Frequency: Frequent (HP:0040282). (ORPHA:521308)
- Bifid nasal tip (HP:0000456): A splitting of the nasal tip. Visually assessable vertical indentation, cleft, or depression of the nasal tip. Evidence: TAS. Frequency: Frequent (HP:0040282). (ORPHA:521308)
- Abnormality of the hand (HP:0001155): An abnormality affecting one or both hands. Evidence: TAS. Frequency: Frequent (HP:0040282). (ORPHA:521308)
- Intrauterine growth retardation (HP:0001511): An abnormal restriction of fetal growth with fetal weight below the tenth percentile for gestational age. Evidence: TAS. Frequency: Frequent (HP:0040282). (ORPHA:521308)
- Downturned corners of mouth (HP:0002714): A morphological abnormality of the mouth in which the angle of the mouth is downturned. The oral commissures are positioned inferior to the midline labial fissure. Evidence: TAS. Frequency: Frequent (HP:0040282). (ORPHA:521308)
- Abnormality of the upper limb (HP:0002817): An abnormality of the arm. Evidence: TAS. Frequency: Frequent (HP:0040282). (ORPHA:521308)
- Clinodactyly of the 5th finger (HP:0004209): Clinodactyly refers to a bending or curvature of the fifth finger in the radial direction (i.e., towards the 4th finger). Evidence: TAS. Frequency: Frequent (HP:0040282). (ORPHA:521308)
- Almond-shaped palpebral fissure (HP:0007874): A shape created by an acute downward arching of the upper eyelid and upward arching of the lower eyelid, toward the medial canthus, which gives the outline of the palpebral fissures the configuration of an almond. Thus, the maximum distance between the fissures is offset from, and medial to, the center point. Evidence: TAS. Frequency: Frequent (HP:0040282). (ORPHA:521308)
- Abnormal nasal bone morphology (HP:0010939): An abnormality of the nasal bone, comprising the left nasal bone and the right nasal bone. Evidence: TAS. Frequency: Frequent (HP:0040282). (ORPHA:521308)
- Choanal atresia (HP:0000453): Absence or abnormal closure of the choana (the posterior nasal aperture). Most embryologists believe that posterior choanal atresia results from a failure of rupture between the 35th and 38th day of fetal life of the partition which separates the bucconasal or buccopharyngeal membranes. The resultant choanal atresia may be unilateral or bilateral, bony or membranous, complete or incomplete. In over 90 per cent of cases the obstruction is bony, while in the remainder it is membranous. The bony type of atresia is commonly located 1-2 mm. anterior to the posterior edge of the hard palate, and the osseous septum varies in thickness from 1 to 10 mm. In the membranous form of choanal atresia the obstruction usually occurs further posteriorly. In approximately one third of cases the atresia is bilateral. Evidence: TAS. Frequency: Occasional (HP:0040283). (ORPHA:521308)
- Agenesis of corpus callosum (HP:0001274): Absence of the corpus callosum as a result of the failure of the corpus callosum to develop, which can be the result of a failure in any one of the multiple steps of callosal development including cellular proliferation and migration, axonal growth or glial patterning at the midline. Evidence: TAS. Frequency: Occasional (HP:0040283). (ORPHA:521308)
- Atrial septal defect (HP:0001631): Atrial septal defect (ASD) is a congenital abnormality of the interatrial septum that enables blood flow between the left and right atria via the interatrial septum. Evidence: TAS. Frequency: Occasional (HP:0040283). (ORPHA:521308)
- Pes planus (HP:0001763): A foot where the longitudinal arch of the foot is in contact with the ground or floor when the individual is standing; or, in a patient lying supine, a foot where the arch is in contact with the surface of a flat board pressed against the sole of the foot by the examiner with a pressure similar to that expected from weight bearing; or, the height of the arch is reduced. Evidence: TAS. Frequency: Occasional (HP:0040283). (ORPHA:521308)
- Frontoethmoidal encephalocele (HP:0007330): A type of anterior encephalocele in which there is a protrusion of the contents of the skull through a breach at the point where the frontal and ethmoidal bones meet. Frontoethmoidal encephalocele can be divided further into three distinct categories: nasofrontal, nasoethmoidal, and nasoorbital. Evidence: TAS. Frequency: Occasional (HP:0040283). (ORPHA:521308)
- Clinodactyly of the 3rd toe (HP:0008115): Bending or curvature of a third toe in the tibial direction (i.e., towards the big toe). Evidence: TAS. Frequency: Occasional (HP:0040283). (ORPHA:521308)
- Oligodactyly (HP:0012165): A developmental defect resulting in the presence of fewer than the normal number of digits. Evidence: TAS. Frequency: Occasional (HP:0040283). (ORPHA:521308)
Not associated with this disease:
- Intellectual disability (HP:0001249): The term intellectual disability or intellectual developmental disorder is used to describe significantly sub-average intellectual and adaptive functioning based on clinical assessment and as measured by individually administered, appropriately normed, standardized and validated tests of intellectual functioning and adaptive behavior, with onset during the developmental period from infancy through adolescence. Evidence: TAS. (ORPHA:521308)